Phenotypes associated with the disease Benign cephalic histiocytosis (ORPHA:157997):
- Skin rash (HP:0000988): A red eruption of the skin. Evidence: TAS. Frequency: Very frequent (HP:0040281). (ORPHA:157997)
- Histiocytosis (HP:0100727): An excessive number of histiocytes (tissue macrophages). Evidence: TAS. Frequency: Very frequent (HP:0040281). (ORPHA:157997)
- Papule (HP:0200034): A circumscribed, solid elevation of skin with no visible fluid, varying in size from a pinhead to less than 10mm in diameter at the widest point. Evidence: TAS. Frequency: Very frequent (HP:0040281). (ORPHA:157997)
- Inflammatory abnormality of the skin (HP:0011123): The presence of inflammation of the skin. That is, an abnormality of the skin resulting from the local accumulation of fluid, plasma proteins, and leukocytes. Evidence: TAS. Frequency: Frequent (HP:0040282). (ORPHA:157997)